- Abnormality of the dentition (HP:0000164): Any abnormality of the teeth. Evidence: PCS. Frequency: 0/4. (PMID:20054564)
- Abnormal nail morphology (HP:0001597): Abnormal structure or appearance of the nail. Evidence: PCS. Frequency: 0/4. (PMID:20054564)
- Hearing abnormality (HP:0000364): An abnormality of the sensory perception of sound. Evidence: PCS. Frequency: 0/4. (PMID:20054564)
- Sparse body hair (HP:0002231): Sparseness of the body hair. Evidence: PCS. Frequency: 4/4. (PMID:20054564)
- Sparse scalp hair (HP:0002209): Decreased number of hairs per unit area of skin of the scalp. Evidence: PCS. Frequency: 4/4. (PMID:20054564)
- Autosomal recessive inheritance (HP:0000007): A mode of inheritance that is observed for traits related to a gene encoded on one of the autosomes (i.e., the human chromosomes 1-22) in which a trait manifests in individuals with two pathogenic alleles, either homozygotes (two copies of the same mutant allele) or compound heterozygotes (whereby each copy of a gene has a distinct mutant allele). Evidence: PCS. (PMID:20054564)
- Hypohidrosis (HP:0000966): Abnormally diminished capacity to sweat. Evidence: PCS. Frequency: 0/4. (PMID:20054564)
- Abnormal eyelash morphology (HP:0000499): An abnormality of the eyelashes. Evidence: PCS. Frequency: 0/4. (PMID:20054564)
- Sparse eyebrow (HP:0045075): Decreased density/number of eyebrow hairs. Evidence: PCS. Frequency: 0/4. (PMID:20054564)
These phenotypes are associated with the disease hypotrichosis 9 (OMIM:614237).